- Hypomature dental enamel (HP:0011085): A form of hypomineralization of enamel characterized by a chalky appearance of the enamel with orange, brown, or white color. Evidence: TAS. (OMIM:613211)
- Amelogenesis imperfecta (HP:0000705): A developmental dysplasia of the dental enamel. Evidence: TAS. (OMIM:613211)
- Enamel hypomineralization (HP:0006285): A decreased amount of enamel mineralization. Hypomineralized enamel has a brown discoloration and brittle aspect. Evidence: TAS. (OMIM:613211)
- Autosomal recessive inheritance (HP:0000007): A mode of inheritance that is observed for traits related to a gene encoded on one of the autosomes (i.e., the human chromosomes 1-22) in which a trait manifests in individuals with two pathogenic alleles, either homozygotes (two copies of the same mutant allele) or compound heterozygotes (whereby each copy of a gene has a distinct mutant allele). Evidence: TAS. (OMIM:613211)
These phenotypes are associated with the disease amelogenesis imperfecta hypomaturation type 2A3 (OMIM:613211).